Phenotypes associated with the disease neurodevelopmental disorder with microcephaly, ataxia, and seizures (OMIM:617709):
- Bilateral tonic-clonic seizure (HP:0002069): A bilateral tonic-clonic seizure is a seizure defined by a tonic (bilateral increased tone, lasting seconds to minutes) and then a clonic (bilateral sustained rhythmic jerking) phase. Evidence: PCS. Frequency: 4/4. Onset: Infantile onset (HP:0003593). (PMID:28236339)
- Microcephaly (HP:0000252): Head circumference below 2 standard deviations below the mean for age and gender. Evidence: PCS. Frequency: 4/4. (PMID:28236339)
- Moderate intellectual disability (HP:0002342): Moderate intellectual disability (ID) is defined as a type of ID characterized by moderately sub-average adaptive functioning and intellectual functioning, with an intelligence quotient (IQ) the range of 35-49. Evidence: PCS. Frequency: 4/4. (PMID:28236339)
- Aggressive behavior (HP:0000718): Behavior or an act aimed at harming a person, animal, or physical property (e.g., acts of physical violence; shouting, swearing, and using harsh language; slashing someone's tires). Evidence: PCS. Frequency: 4/4. (PMID:28236339)
- Global developmental delay (HP:0001263): A delay in the achievement of motor or mental milestones in the domains of development of a child, including motor skills, speech and language, cognitive skills, and social and emotional skills. This term should only be used to describe children younger than five years of age. Evidence: PCS. Frequency: 4/4. (PMID:28236339)
- Ataxia (HP:0001251): Ataxia refers to impaired coordination of voluntary muscle movement. Cerebellar ataxia refers to ataxia due to dysfunction of the cerebellum. This causes a variety of elementary neurological deficits including asynergy (lack of coordination between muscles, limbs and joints), dysmetria (lack of ability to judge distances that can lead to under- or overshoot in grasping movements), and dysdiadochokinesia (inability to perform rapid movements requiring antagonizing muscle groups to be switched on and off repeatedly). Evidence: PCS. Frequency: 4/4. (PMID:28236339)
- Infantile onset (HP:0003593): Onset of signs or symptoms of disease between 28 days to one year of life. Evidence: PCS. Frequency: 4/4. (PMID:28236339)
- Autosomal recessive inheritance (HP:0000007): A mode of inheritance that is observed for traits related to a gene encoded on one of the autosomes (i.e., the human chromosomes 1-22) in which a trait manifests in individuals with two pathogenic alleles, either homozygotes (two copies of the same mutant allele) or compound heterozygotes (whereby each copy of a gene has a distinct mutant allele). Evidence: PCS. (PMID:28236339)
- Muscle weakness (HP:0001324): Reduced strength of muscles. Evidence: PCS. Frequency: 4/4. Onset: Juvenile onset (HP:0003621). (PMID:28236339)
- Slender build (HP:0001533): Asthenic habitus refers to a slender build with long limbs, an angular profile, and prominent muscles or bones. Evidence: PCS. Frequency: 2/4. (PMID:28236339)
- Pes planus (HP:0001763): A foot where the longitudinal arch of the foot is in contact with the ground or floor when the individual is standing; or, in a patient lying supine, a foot where the arch is in contact with the surface of a flat board pressed against the sole of the foot by the examiner with a pressure similar to that expected from weight bearing; or, the height of the arch is reduced. Evidence: PCS. Frequency: 2/4. (PMID:28236339)